Phenotypes associated with the disease autosomal dominant nonsyndromic hearing loss 11 (OMIM:601317):
- Bilateral sensorineural hearing impairment (HP:0008619): A form of sensorineural hearing impairment that affects both ears. Evidence: TAS. (OMIM:601317)
- Abnormal vestibular function (HP:0001751): An abnormality of the functioning of the vestibular apparatus. Evidence: TAS. (OMIM:601317)
- Vertigo (HP:0002321): An abnormal sensation of spinning while the body is actually stationary. Evidence: TAS. (OMIM:601317)
- Autosomal dominant inheritance (HP:0000006): A mode of inheritance that is observed for traits related to a gene encoded on one of the autosomes (i.e., the human chromosomes 1-22) in which a trait manifests in heterozygotes. In the context of medical genetics, an autosomal dominant disorder is caused when a single copy of the mutant allele is present. Males and females are affected equally, and can both transmit the disorder with a risk of 50% for each child of inheriting the mutant allele. Evidence: TAS. (OMIM:601317)